Phenotypes associated with the disease Progressive myoclonic epilepsy type 3 (ORPHA:263516):
- Intellectual disability (HP:0001249): The term intellectual disability or intellectual developmental disorder is used to describe significantly sub-average intellectual and adaptive functioning based on clinical assessment and as measured by individually administered, appropriately normed, standardized and validated tests of intellectual functioning and adaptive behavior, with onset during the developmental period from infancy through adolescence. Evidence: TAS. Frequency: Frequent (HP:0040282). (ORPHA:263516)
- Dysarthria (HP:0001260): Dysarthric speech is a general description referring to a neurological speech disorder characterized by poor articulation. Depending on the involved neurological structures, dysarthria may be further classified as spastic, flaccid, ataxic, hyperkinetic and hypokinetic, or mixed. Evidence: TAS. Frequency: Frequent (HP:0040282). (ORPHA:263516)
- Myoclonus (HP:0001336): Very brief, involuntary random muscular contractions occurring at rest, in response to sensory stimuli, or accompanying voluntary movements. Evidence: TAS. Frequency: Frequent (HP:0040282). (ORPHA:263516)
- Developmental regression (HP:0002376): Loss of developmental skills, as manifested by loss of developmental milestones. Evidence: TAS. Frequency: Frequent (HP:0040282). (ORPHA:263516)
- Progressive truncal ataxia (HP:0007221). Evidence: TAS. Frequency: Frequent (HP:0040282). (ORPHA:263516)
- Progressive psychomotor deterioration (HP:0007272). Evidence: TAS. Frequency: Frequent (HP:0040282). (ORPHA:263516)
- Focal myoclonic seizure (HP:0011166): A type of focal motor seizure characterized by sudden, brief (<100 ms) involuntary single or multiple contraction(s) of muscles(s) or muscle groups of variable topography (axial, proximal limb, distal). Myoclonus is less regularly repetitive and less sustained than is clonus. Evidence: TAS. Frequency: Frequent (HP:0040282). (ORPHA:263516)
- Focal EEG discharges with secondary generalization (HP:0011188): Focal EEG discharges that secondarily spread to both hemispheres and can then be recorded over the entire scalp. Evidence: TAS. Frequency: Frequent (HP:0040282). (ORPHA:263516)
- Microcephaly (HP:0000252): Head circumference below 2 standard deviations below the mean for age and gender. Evidence: TAS. Frequency: Occasional (HP:0040283). (ORPHA:263516)
- Abnormality of vision (HP:0000504): Abnormality of eyesight (visual perception). Evidence: TAS. Frequency: Occasional (HP:0040283). (ORPHA:263516)
- Optic atrophy (HP:0000648): Atrophy of the optic nerve. Optic atrophy results from the death of the retinal ganglion cell axons that comprise the optic nerve and manifesting as a pale optic nerve on fundoscopy. Evidence: TAS. Frequency: Occasional (HP:0040283). (ORPHA:263516)
- Dementia (HP:0000726): A loss of global cognitive ability of sufficient amount to interfere with normal social or occupational function. Dementia represents a loss of previously present cognitive abilities, generally in adults, and can affect memory, thinking, language, judgment, and behavior. Evidence: TAS. Frequency: Occasional (HP:0040283). (ORPHA:263516)
- Cerebellar atrophy (HP:0001272): Cerebellar atrophy is defined as a cerebellum with initially normal structures, in a posterior fossa with normal size, which displays enlarged fissures (interfolial spaces) in comparison to the foliae secondary to loss of tissue. Cerebellar atrophy implies irreversible loss of tissue and result from an ongoing progressive disease until a final stage is reached or a single injury, e.g. an intoxication or infectious event. Evidence: TAS. Frequency: Occasional (HP:0040283). (ORPHA:263516)
- Photosensitive myoclonic seizure (HP:0001327): Generalised myoclonic seizure provoked by flashing or flickering light. Evidence: TAS. Frequency: Occasional (HP:0040283). (ORPHA:263516)
- Cerebral atrophy (HP:0002059): Atrophy (wasting, decrease in size of cells or tissue) affecting the cerebrum. Evidence: TAS. Frequency: Occasional (HP:0040283). (ORPHA:263516)
- Bilateral tonic-clonic seizure (HP:0002069): A bilateral tonic-clonic seizure is a seizure defined by a tonic (bilateral increased tone, lasting seconds to minutes) and then a clonic (bilateral sustained rhythmic jerking) phase. Evidence: TAS. Frequency: Occasional (HP:0040283). (ORPHA:263516)
- Progressive cerebellar ataxia (HP:0002073). Evidence: TAS. Frequency: Occasional (HP:0040283). (ORPHA:263516)
- Febrile seizure (within the age range of 3 months to 6 years) (HP:0002373): A febrile seizure is any type of seizure (most often a generalized tonic-clonic seizure) occurring with fever (at least 38 degrees Celsius) but in the absence of central nervous system infection, severe metabolic disturbance or other alternative precipitant in children between the ages of 3 months and 6 years. Evidence: TAS. Frequency: Occasional (HP:0040283). (ORPHA:263516)
- Aplasia/Hypoplasia of the corpus callosum (HP:0007370): Absence or underdevelopment of the corpus callosum. Evidence: TAS. Frequency: Occasional (HP:0040283). (ORPHA:263516)
- EEG with focal epileptiform discharges (HP:0011185): EEG discharges recorded in particular areas of a localized (focal) abnormality in cerebral electrical activity recorded along the scalp by electroencephalography (EEG). Evidence: TAS. Frequency: Occasional (HP:0040283). (ORPHA:263516)
- Chin myoclonus (HP:0012462): Involuntary and irregular twitches of the chin. Evidence: TAS. Frequency: Occasional (HP:0040283). (ORPHA:263516)
- Limb myoclonus (HP:0045084). Evidence: TAS. Frequency: Occasional (HP:0040283). (ORPHA:263516)